Phenotypes associated with the disease porokeratosis 6, disseminated superficial actinic type (OMIM:612353):
- Porokeratosis (HP:0200044): A clonal disorder of keratinization with one or multiple atrophic patches surrounded by a clinically and histologically distinctive hyperkeratotic ridgelike border called the cornoid lamella. Evidence: TAS. (OMIM:612353)
- Autosomal dominant inheritance (HP:0000006): A mode of inheritance that is observed for traits related to a gene encoded on one of the autosomes (i.e., the human chromosomes 1-22) in which a trait manifests in heterozygotes. In the context of medical genetics, an autosomal dominant disorder is caused when a single copy of the mutant allele is present. Males and females are affected equally, and can both transmit the disorder with a risk of 50% for each child of inheriting the mutant allele. Evidence: TAS. (OMIM:612353)